Phenotypes associated with the disease Tenosynovial giant cell tumor (ORPHA:66627):
- Arthralgia (HP:0002829): Joint pain. Evidence: TAS. Frequency: Very frequent (HP:0040281). (ORPHA:66627)
- Arthritis (HP:0001369): Inflammation of a joint. Evidence: TAS. Frequency: Frequent (HP:0040282). (ORPHA:66627)
- Limitation of joint mobility (HP:0001376): A reduction in the freedom of movement of one or more joints. Evidence: TAS. Frequency: Frequent (HP:0040282). (ORPHA:66627)
- Joint swelling (HP:0001386). Evidence: TAS. Frequency: Frequent (HP:0040282). (ORPHA:66627)
- Joint stiffness (HP:0001387): Joint stiffness is a perceived sensation of tightness in a joint or joints when attempting to move them after a period of inactivity. Joint stiffness typically subsides over time. Evidence: TAS. Frequency: Frequent (HP:0040282). (ORPHA:66627)
- Osteolysis (HP:0002797): Osteolysis refers to the destruction of bone through bone resorption with removal or loss of calcium. Evidence: TAS. Frequency: Frequent (HP:0040282). (ORPHA:66627)
- Abnormality of the knee (HP:0002815): An abnormality of the knee joint or surrounding structures. Evidence: TAS. Frequency: Frequent (HP:0040282). (ORPHA:66627)
- Joint hemorrhage (HP:0005261): Hemorrhage occurring within a joint. Evidence: TAS. Frequency: Frequent (HP:0040282). (ORPHA:66627)
- Abnormal auditory canal morphology (HP:0000372): Any structural abnormality of the external acoustic tube (also known as the auditory canal). Evidence: TAS. Frequency: Occasional (HP:0040283). (ORPHA:66627)
- Conductive hearing impairment (HP:0000405): An abnormality of vibrational conductance of sound to the inner ear leading to impairment of sensory perception of sound. Evidence: TAS. Frequency: Occasional (HP:0040283). (ORPHA:66627)
- Multiple lentigines (HP:0001003): Presence of an unusually high number of lentigines (singular: lentigo), which are flat, tan to brown oval spots. Evidence: TAS. Frequency: Occasional (HP:0040283). (ORPHA:66627)
- Lymphedema (HP:0001004): Localized fluid retention and tissue swelling caused by a compromised lymphatic system. Evidence: TAS. Frequency: Occasional (HP:0040283). (ORPHA:66627)
- Abnormal hip joint morphology (HP:0001384): An abnormality of the hip joint. Evidence: TAS. Frequency: Occasional (HP:0040283). (ORPHA:66627)
- Abnormality of the wrist (HP:0003019): Abnormality of the wrist, the structure connecting the hand and the forearm. Evidence: TAS. Frequency: Occasional (HP:0040283). (ORPHA:66627)
- Abnormality of the ankle (HP:0003028): An anomaly of the joint that connects the foot with the leg. Evidence: TAS. Frequency: Occasional (HP:0040283). (ORPHA:66627)
- Abnormal shoulder morphology (HP:0003043): An abnormality of the shoulder, which is defined as the structures surrounding the shoulder joint where the humerus attaches to the scapula. Evidence: TAS. Frequency: Occasional (HP:0040283). (ORPHA:66627)
- Abnormality of the elbow (HP:0009811): An anomaly of the joint that connects the upper and the lower arm. Evidence: TAS. Frequency: Occasional (HP:0040283). (ORPHA:66627)
- Abnormal temporal bone morphology (HP:0009911): Abnormality of the temporal bone of the skull, which is situated at the sides and base of the skull roughly underlying the region of the face known as the temple. Evidence: TAS. Frequency: Occasional (HP:0040283). (ORPHA:66627)
- Groin pain (HP:0031520): An unpleasant sensation characterized by physical discomfort (such as pricking, throbbing, or aching) localized to the groin region. Evidence: TAS. Frequency: Occasional (HP:0040283). (ORPHA:66627)
- Abnormal tympanic membrane morphology (HP:0040090): Any structural abnormality of the tympanic membrane. Evidence: TAS. Frequency: Occasional (HP:0040283). (ORPHA:66627)
- Chondrocalcinosis (HP:0000934): Radiographic evidence of articular calcification that represent calcium pyrophosphate depositions in soft tissue surrounding joints and at the insertions of tendons near joints (Entheses/Sharpey fibers) . Evidence: TAS. Frequency: Very rare (HP:0040284). (ORPHA:66627)
- Synovial lining hyperplasia (HP:0005186): Synovial hyperplasia involves proliferation of mesenchymal stromal/stem cells and leads to synovial thickening, which can be observed radiographically. Evidence: TAS. Frequency: Very rare (HP:0040284). (ORPHA:66627)
- Polyarticular arthropathy (HP:0005195). Evidence: TAS. Frequency: Very rare (HP:0040284). (ORPHA:66627)
- Localized osteoporosis (HP:0040161). Evidence: TAS. Frequency: Very rare (HP:0040284). (ORPHA:66627)